- Moderate intellectual disability (HP:0002342): Moderate intellectual disability (ID) is defined as a type of ID characterized by moderately sub-average adaptive functioning and intellectual functioning, with an intelligence quotient (IQ) the range of 35-49. Evidence: TAS. (OMIM:611096)
- Seizure (HP:0001250): A seizure is an intermittent abnormality of nervous system physiology characterized by a transient occurrence of signs and/or symptoms due to abnormal excessive or synchronous neuronal activity in the brain. Evidence: TAS. Frequency: Occasional (HP:0040283). (OMIM:611096)
- Autosomal recessive inheritance (HP:0000007): A mode of inheritance that is observed for traits related to a gene encoded on one of the autosomes (i.e., the human chromosomes 1-22) in which a trait manifests in individuals with two pathogenic alleles, either homozygotes (two copies of the same mutant allele) or compound heterozygotes (whereby each copy of a gene has a distinct mutant allele). Evidence: TAS. (OMIM:611096)
- Motor delay (HP:0001270): A type of Developmental delay characterized by a delay in acquiring motor skills. Evidence: TAS. (OMIM:611096)
These phenotypes are associated with the disease intellectual disability, autosomal recessive 10 (OMIM:611096).